- Autosomal recessive inheritance (HP:0000007): A mode of inheritance that is observed for traits related to a gene encoded on one of the autosomes (i.e., the human chromosomes 1-22) in which a trait manifests in individuals with two pathogenic alleles, either homozygotes (two copies of the same mutant allele) or compound heterozygotes (whereby each copy of a gene has a distinct mutant allele). Evidence: PCS. (PMID:27494380)
- White scaling skin (HP:0040190). Evidence: PCS. (PMID:27494380)
These phenotypes are associated with the disease ichthyosis, congenital, autosomal recessive 12 (OMIM:617320).